- High palate (HP:0000218): Height of the palate more than 2 SD above the mean (objective) or palatal height at the level of the first permanent molar more than twice the height of the teeth (subjective). Evidence: TAS. Frequency: Very frequent (HP:0040281). (ORPHA:2632)
- Abnormal carpal morphology (HP:0001191): An abnormality affecting the carpal bones of the wrist (scaphoid, lunate, triquetral, pisiform, trapezium, trapezoid, capitate, hamate). Evidence: TAS. Frequency: Very frequent (HP:0040281). (ORPHA:2632)
- Micromelia (HP:0002983): The presence of abnormally small extremities. Evidence: TAS. Frequency: Very frequent (HP:0040281). (ORPHA:2632)
- Madelung deformity (HP:0003067): An anomaly related to partial closure, or failure of development of the ulnar side of the distal radial growth plate, which results in an arrest of epiphyseal growth of the medial and volar portions of the distal radius. This leads to shortening of the radius and relative overgrowth of the ulna. Evidence: TAS. Frequency: Very frequent (HP:0040281). (ORPHA:2632)
- Severe short stature (HP:0003510): A severe degree of short stature, more than -4 SD from the mean corrected for age and sex. Evidence: TAS. Frequency: Very frequent (HP:0040281). (ORPHA:2632)
- Mesomelic/rhizomelic limb shortening (HP:0005026). Evidence: TAS. Frequency: Very frequent (HP:0040281). (ORPHA:2632)
- Abnormal epiphysis morphology (HP:0005930): An anomaly of epiphysis, which is the expanded articular end of a long bone that developes from a secondary ossification center, and which during the period of growth is either entirely cartilaginous or is separated from the shaft by a cartilaginous disk. Evidence: TAS. Frequency: Very frequent (HP:0040281). (ORPHA:2632)
- Bowing of the long bones (HP:0006487): A bending or abnormal curvature of a long bone. Evidence: TAS. Frequency: Very frequent (HP:0040281). (ORPHA:2632)
- Aplasia/Hypoplasia of the fibula (HP:0006492): Absence or underdevelopment of the fibula. Evidence: TAS. Frequency: Very frequent (HP:0040281). (ORPHA:2632)
- Disproportionate short-limb short stature (HP:0008873): A type of disproportionate short stature characterized by a short limbs but an average-sized trunk. Evidence: TAS. Frequency: Very frequent (HP:0040281). (ORPHA:2632)
- Ulnar deviation of finger (HP:0009465): Bending or curvature of a finger toward the ulnar side (i.e., away from the thumb). The deviation is at the metacarpal-phalangeal joint, and this finding is distinct from clinodactyly. Evidence: TAS. Frequency: Very frequent (HP:0040281). (ORPHA:2632)
- Abnormal morphology of ulna (HP:0040071): Any structural anomaly of the ulna, a bone of the forearm the extends from the elbow to the little finger. Evidence: TAS. Frequency: Very frequent (HP:0040281). (ORPHA:2632)
- Short femoral neck (HP:0100864): An abnormally short femoral neck (which is the process of bone, connecting the femoral head with the femoral shaft). Evidence: TAS. Frequency: Very frequent (HP:0040281). (ORPHA:2632)
These phenotypes are associated with the disease Langer mesomelic dysplasia (ORPHA:2632).